- Autosomal recessive inheritance (HP:0000007): A mode of inheritance that is observed for traits related to a gene encoded on one of the autosomes (i.e., the human chromosomes 1-22) in which a trait manifests in individuals with two pathogenic alleles, either homozygotes (two copies of the same mutant allele) or compound heterozygotes (whereby each copy of a gene has a distinct mutant allele). Evidence: PCS. (PMID:29726989)
- Reduced visual acuity (HP:0007663). Evidence: PCS. Frequency: 2/2. Onset: Juvenile onset (HP:0003621). (PMID:29726989)
- Progressive night blindness (HP:0007675). Evidence: PCS. Frequency: 2/2. (PMID:29726989)
- Rod-cone dystrophy (HP:0000510): An inherited retinal disease subtype in which the rod photoreceptors appear to be more severely affected than the cone photoreceptors. Typical presentation is with nyctalopia (due to rod dysfunction) followed by loss of mid-peripheral field of vision, which gradually extends and leaves many patients with a small central island of vision due to the preservation of macular cones. Evidence: PCS. (PMID:29726989)
These phenotypes are associated with the disease retinitis pigmentosa 85 (OMIM:618345).